Phenotypes associated with the disease Hidrotic ectodermal dysplasia, Christianson-Fourie type (ORPHA:1808):
- Sparse eyelashes (HP:0000653): Decreased density/number of eyelashes. Evidence: TAS. Frequency: Very frequent (HP:0040281). (ORPHA:1808)
- Abnormal hair morphology (HP:0001595): An abnormality of the hair. Evidence: TAS. Frequency: Very frequent (HP:0040281). (ORPHA:1808)
- Abnormal nail morphology (HP:0001597): Abnormal structure or appearance of the nail. Evidence: TAS. Frequency: Very frequent (HP:0040281). (ORPHA:1808)
- Sparse scalp hair (HP:0002209): Decreased number of hairs per unit area of skin of the scalp. Evidence: TAS. Frequency: Very frequent (HP:0040281). (ORPHA:1808)
- Sparse axillary hair (HP:0002215): Reduced number or density of axillary hair. Evidence: TAS. Frequency: Frequent (HP:0040282). (ORPHA:1808)
- Absent eyebrow (HP:0002223): Absence of the eyebrow. Evidence: TAS. Frequency: Very frequent (HP:0040281). (ORPHA:1808)
- Sparse pubic hair (HP:0002225): Reduced number or density of pubic hair. Evidence: TAS. Frequency: Frequent (HP:0040282). (ORPHA:1808)
- Onychogryphosis of toenails (HP:0008401): Thickened toenails. Evidence: TAS. Frequency: Very frequent (HP:0040281). (ORPHA:1808)
- Nail dystrophy (HP:0008404): Onychodystrophy (nail dystrophy) refers to nail changes apart from changes of the color (nail dyschromia) and involves partial or complete disruption of the various keratinous layers of the nail plate. Evidence: TAS. Frequency: Very frequent (HP:0040281). (ORPHA:1808)
- Arrhythmia (HP:0011675): Any cardiac rhythm other than the normal sinus rhythm. Such a rhythm may be either of sinus or ectopic origin and either regular or irregular. An arrhythmia may be due to a disturbance in impulse formation or conduction or both. Evidence: TAS. Frequency: Occasional (HP:0040283). (ORPHA:1808)